- Long face (HP:0000276): Facial height (length) is more than 2 standard deviations above the mean (objective); or, an apparent increase in the height (length) of the face (subjective). Evidence: TAS. Frequency: Very frequent (HP:0040281). (ORPHA:3044)
- Mandibular prognathia (HP:0000303): Abnormal prominence of the chin related to increased length of the mandible. Evidence: TAS. Frequency: Very frequent (HP:0040281). (ORPHA:3044)
- Wide nose (HP:0000445): Interalar distance more than two standard deviations above the mean for age, i.e., an apparently increased width of the nasal base and alae. Evidence: TAS. Frequency: Very frequent (HP:0040281). (ORPHA:3044)
- Deeply set eye (HP:0000490): An eye that is more deeply recessed into the plane of the face than is typical. Evidence: TAS. Frequency: Very frequent (HP:0040281). (ORPHA:3044)
- Global developmental delay (HP:0001263): A delay in the achievement of motor or mental milestones in the domains of development of a child, including motor skills, speech and language, cognitive skills, and social and emotional skills. This term should only be used to describe children younger than five years of age. Evidence: TAS. Frequency: Very frequent (HP:0040281). (ORPHA:3044)
- Abnormal facial shape (HP:0001999): An abnormal morphology (form) of the face or its components. Evidence: TAS. Frequency: Very frequent (HP:0040281). (ORPHA:3044)
- Sparse pubic hair (HP:0002225): Reduced number or density of pubic hair. Evidence: TAS. Frequency: Very frequent (HP:0040281). (ORPHA:3044)
- Moderate intellectual disability (HP:0002342): Moderate intellectual disability (ID) is defined as a type of ID characterized by moderately sub-average adaptive functioning and intellectual functioning, with an intelligence quotient (IQ) the range of 35-49. Evidence: TAS. Frequency: Very frequent (HP:0040281). (ORPHA:3044)
- Cleft ala nasi (HP:0003191): The presence of a notch in the margin of the ala nasi. Evidence: TAS. Frequency: Very frequent (HP:0040281). (ORPHA:3044)
- Eunuchoid habitus (HP:0003782): A body habitus that is tall, slim and underweight, with long legs and long arms (i.e., arm span exceeds height by 5 cm or more). Evidence: TAS. Frequency: Very frequent (HP:0040281). (ORPHA:3044)
- Elevated circulating follicle stimulating hormone level (HP:0008232): An elevated concentration of follicle-stimulating hormone in the blood. Evidence: TAS. Frequency: Very frequent (HP:0040281). (ORPHA:3044)
- Decreased testicular size (HP:0008734): Reduced volume of the testicle (the male gonad). Evidence: TAS. Frequency: Very frequent (HP:0040281). (ORPHA:3044)
- Elevated circulating luteinizing hormone level (HP:0011969): An elevated concentration of luteinizing hormone in the blood. Evidence: TAS. Frequency: Very frequent (HP:0040281). (ORPHA:3044)
- Narrow nasal base (HP:0012809): Decreased distance between the attachments of the alae nasi to the face. Evidence: TAS. Frequency: Very frequent (HP:0040281). (ORPHA:3044)
- Decreased serum testosterone concentration (HP:0040171). Evidence: TAS. Frequency: Very frequent (HP:0040281). (ORPHA:3044)
- Type I diabetes mellitus (HP:0100651): A chronic condition in which the pancreas produces little or no insulin. Type I diabetes mellitus is manifested by the sudden onset of severe hyperglycemia with rapid progression to diabetic ketoacidosis unless treated with insulin. Evidence: TAS. Frequency: Very frequent (HP:0040281). (ORPHA:3044)
- Bilateral tonic-clonic seizure (HP:0002069): A bilateral tonic-clonic seizure is a seizure defined by a tonic (bilateral increased tone, lasting seconds to minutes) and then a clonic (bilateral sustained rhythmic jerking) phase. Evidence: TAS. Frequency: Frequent (HP:0040282). (ORPHA:3044)
- Floppy infant (HP:0008947): Floppiness/hypotonia is defined as reduced resistance to passive movement of joints. Physical examination of floppy/hypotonic infants shows head lag, lack of shoulder and elbow muscle contraction on traction response, inability to tighten the shoulder girdle muscles (or slipping through) when held under the axillae, scarf sign (when the arm is pulled to the opposite side, the arm wraps around the neck with the elbow crossing midline), hyperdorsiflexion of the feet, easy apposition of the thumb against the forearm, feet touching the cheek with ease and without discomfort, frog leg position, and inverted U sign on ventral suspension (head, arms, and legs hanging down without elbow or knee flexion and the trunk rounded in a dome shape). Evidence: TAS. Frequency: Frequent (HP:0040282). (ORPHA:3044)
- Breast aplasia (HP:0100783): Failure to develop and congenital absence of the breast. Evidence: TAS. Frequency: Frequent (HP:0040282). (ORPHA:3044)
- Hypoplasia of the maxilla (HP:0000327): Abnormally small dimension of the Maxilla. Usually creating a malocclusion or malalignment between the upper and lower teeth or resulting in a deficient amount of projection of the base of the nose and lower midface region. Evidence: TAS. Frequency: Occasional (HP:0040283). (ORPHA:3044)
- Febrile seizure (within the age range of 3 months to 6 years) (HP:0002373): A febrile seizure is any type of seizure (most often a generalized tonic-clonic seizure) occurring with fever (at least 38 degrees Celsius) but in the absence of central nervous system infection, severe metabolic disturbance or other alternative precipitant in children between the ages of 3 months and 6 years. Evidence: TAS. Frequency: Occasional (HP:0040283). (ORPHA:3044)
- Pelvic girdle muscle atrophy (HP:0008988): Muscular atrophy affecting the muscles that attach to the pelvic girdle (the gluteal muscles, the lateral rotators, adductor magnus, adductor brevis, adductor longus, pectineus, and gracilis muscles). Evidence: TAS. Frequency: Occasional (HP:0040283). (ORPHA:3044)
These phenotypes are associated with the disease Intellectual disability-dysmorphism-hypogonadism-diabetes mellitus syndrome (ORPHA:3044).